Phenotypes associated with the disease Abruzzo-Erickson syndrome (ORPHA:921):
- Cryptorchidism (HP:0000028): Testis in inguinal canal. That is, absence of one or both testes from the scrotum owing to failure of the testis or testes to descend through the inguinal canal to the scrotum. Evidence: TAS. Frequency: Occasional (HP:0040283). (ORPHA:921)
- Hypospadias (HP:0000047): Abnormal position of urethral meatus on the ventral penile shaft (underside) characterized by displacement of the urethral meatus from the tip of the glans penis to the ventral surface of the penis, scrotum, or perineum. Evidence: TAS. Frequency: Very frequent (HP:0040281). (ORPHA:921)
- Abnormal palate morphology (HP:0000174): Any abnormality of the palate, i.e., of roof of the mouth. Evidence: TAS. Frequency: Frequent (HP:0040282). (ORPHA:921)
- Cleft palate (HP:0000175): Cleft palate is a developmental defect of the palate resulting from a failure of fusion of the palatine processes and manifesting as a separation of the roof of the mouth (soft and hard palate). Evidence: TAS. Frequency: Very frequent (HP:0040281). (ORPHA:921)
- Malar flattening (HP:0000272): Underdevelopment of the malar prominence of the jugal bone (zygomatic bone in mammals), appreciated in profile, frontal view, and/or by palpation. Evidence: TAS. Frequency: Very frequent (HP:0040281). (ORPHA:921)
- Epicanthus (HP:0000286): A fold of skin starting above the medial aspect of the upper eyelid and arching downward to cover, pass in front of and lateral to the medial canthus. Evidence: TAS. Frequency: Occasional (HP:0040283). (ORPHA:921)
- Macrotia (HP:0000400): Median longitudinal ear length greater than two standard deviations above the mean and median ear width greater than two standard deviations above the mean (objective); or, apparent increase in length and width of the pinna (subjective). Evidence: TAS. Frequency: Very frequent (HP:0040281). (ORPHA:921)
- Conductive hearing impairment (HP:0000405): An abnormality of vibrational conductance of sound to the inner ear leading to impairment of sensory perception of sound. Evidence: TAS. Frequency: Occasional (HP:0040283). (ORPHA:921)
- Sensorineural hearing impairment (HP:0000407): A type of hearing impairment in one or both ears related to an abnormal functionality of the cochlear nerve. Evidence: TAS. Frequency: Frequent (HP:0040282). (ORPHA:921)
- Microcornea (HP:0000482): A congenital abnormality of the cornea in which the cornea and the anterior segment of the eye are smaller than normal. The horizontal diameter of the cornea does not reach 10 mm even in adulthood. Evidence: TAS. Frequency: Occasional (HP:0040283). (ORPHA:921)
- Chorioretinal coloboma (HP:0000567): Absence of a region of the retina, retinal pigment epithelium, and choroid. Evidence: TAS. Frequency: Frequent (HP:0040282). (ORPHA:921)
- Coloboma (HP:0000589): A developmental defect characterized by a cleft of some portion of the eye or ocular adnexa. Evidence: TAS. Frequency: Frequent (HP:0040282). (ORPHA:921)
- Iris coloboma (HP:0000612): A coloboma of the iris. Evidence: TAS. Frequency: Frequent (HP:0040282). (ORPHA:921)
- Brachydactyly (HP:0001156): Digits that appear disproportionately short compared to the hand/foot. The word brachydactyly is used here to describe a series distinct patterns of shortened digits (brachydactyly types A-E). This is the sense used here. Evidence: TAS. Frequency: Occasional (HP:0040283). (ORPHA:921)
- Atrial septal defect (HP:0001631): Atrial septal defect (ASD) is a congenital abnormality of the interatrial septum that enables blood flow between the left and right atria via the interatrial septum. Evidence: TAS. Frequency: Occasional (HP:0040283). (ORPHA:921)
- Toe syndactyly (HP:0001770): Webbing or fusion of the toes, involving soft parts only or including bone structure. Bony fusions are referred to as "bony" Syndactyly if the fusion occurs in a radio-ulnar axis. Fusions of bones of the toes in a proximo-distal axis are referred to as "Symphalangism". Evidence: TAS. Frequency: Occasional (HP:0040283). (ORPHA:921)
- Short toe (HP:0001831): A toe that appears disproportionately short compared to the foot. Evidence: TAS. Frequency: Occasional (HP:0040283). (ORPHA:921)
- Radioulnar synostosis (HP:0002974): An abnormal osseous union (fusion) between the radius and the ulna. Evidence: TAS. Frequency: Frequent (HP:0040282). (ORPHA:921)
- Short stature (HP:0004322): A height below that which is expected according to age and gender norms. Although there is no universally accepted definition of short stature, many refer to "short stature" as height more than 2 standard deviations below the mean for age and gender (or below the 3rd percentile for age and gender dependent norms). Evidence: TAS. Frequency: Frequent (HP:0040282). (ORPHA:921)
- Coronal hypospadias (HP:0008743): A mild form of hypospadias in which the urethra opens just under the corona glandis, that is, where the head of the penis meets the shaft. Evidence: TAS. Frequency: Very frequent (HP:0040281). (ORPHA:921)
- Ulnar deviation of finger (HP:0009465): Bending or curvature of a finger toward the ulnar side (i.e., away from the thumb). The deviation is at the metacarpal-phalangeal joint, and this finding is distinct from clinodactyly. Evidence: TAS. Frequency: Frequent (HP:0040282). (ORPHA:921)
- Dimple chin (HP:0010751): A persistent midline depression of the skin over the fat pad of the chin. Evidence: TAS. Frequency: Occasional (HP:0040283). (ORPHA:921)
- Flat face (HP:0012368): Absence of concavity or convexity of the face when viewed in profile. Evidence: TAS. Frequency: Very frequent (HP:0040281). (ORPHA:921)
- Abnormal localization of kidney (HP:0100542): An abnormal site of the kidney. Evidence: TAS. Frequency: Occasional (HP:0040283). (ORPHA:921)